Phenotypes associated with the disease X-linked alpha-thalassemia-intellectual disability syndrome (ORPHA:847):
- Optic atrophy (HP:0000648): Atrophy of the optic nerve. Optic atrophy results from the death of the retinal ganglion cell axons that comprise the optic nerve and manifesting as a pale optic nerve on fundoscopy. Evidence: TAS. Frequency: Occasional (HP:0040283). (ORPHA:847)
- Depression (HP:0000716): Frequently experiencing feelings of being down, miserable, and/or hopeless; struggling to recover from these moods; having a pessimistic outlook on the future; feeling a pervasive sense of shame; having a low self-worth; experiencing thoughts of suicide and engaging in suicidal behavior. Evidence: TAS. Frequency: Occasional (HP:0040283). (ORPHA:847)
- Osteoporosis (HP:0000939): Osteoporosis is a systemic skeletal disease characterized by low bone density and microarchitectural deterioration of bone tissue with a consequent increase in bone fragility. According to the WHO criteria, osteoporosis is defined as a BMD that lies 2.5 standard deviations or more below the average value for young healthy adults (a T-score below -2.5 SD). Evidence: TAS. Frequency: Occasional (HP:0040283). (ORPHA:847)
- Brachydactyly (HP:0001156): Digits that appear disproportionately short compared to the hand/foot. The word brachydactyly is used here to describe a series distinct patterns of shortened digits (brachydactyly types A-E). This is the sense used here. Evidence: TAS. Frequency: Occasional (HP:0040283). (ORPHA:847)
- Hypotonia (HP:0001252): Hypotonia is an abnormally low muscle tone (the amount of tension or resistance to movement in a muscle). Even when relaxed, muscles have a continuous and passive partial contraction which provides some resistance to passive stretching. Hypotonia thus manifests as diminished resistance to passive stretching. Hypotonia is not the same as muscle weakness, although the two conditions can co-exist. Evidence: TAS. Frequency: Occasional (HP:0040283). (ORPHA:847)
- Spastic paraplegia (HP:0001258): Complete loss of the ability to move the lower limbs accompanied by spasticity of the lower limbs. Evidence: TAS. Frequency: Occasional (HP:0040283). (ORPHA:847)
- Agenesis of corpus callosum (HP:0001274): Absence of the corpus callosum as a result of the failure of the corpus callosum to develop, which can be the result of a failure in any one of the multiple steps of callosal development including cellular proliferation and migration, axonal growth or glial patterning at the midline. Evidence: TAS. Frequency: Occasional (HP:0040283). (ORPHA:847)
- Flexion contracture (HP:0001371): A flexion contracture is a bent (flexed) joint that cannot be straightened actively or passively. It is thus a chronic loss of joint motion due to structural changes in muscle, tendons, ligaments, or skin that prevents normal movement of joints. Evidence: TAS. Frequency: Occasional (HP:0040283). (ORPHA:847)
- Joint stiffness (HP:0001387): Joint stiffness is a perceived sensation of tightness in a joint or joints when attempting to move them after a period of inactivity. Joint stiffness typically subsides over time. Evidence: TAS. Frequency: Occasional (HP:0040283). (ORPHA:847)
- Growth delay (HP:0001510): A deficiency or slowing down of growth pre- and postnatally. Evidence: TAS. Frequency: Occasional (HP:0040283). (ORPHA:847)
- Death in infancy (HP:0001522): Death within the first 24 months of life. Evidence: TAS. Frequency: Occasional (HP:0040283). (ORPHA:847)
- Abnormal heart morphology (HP:0001627): Any structural anomaly of the heart. Evidence: TAS. Frequency: Occasional (HP:0040283). (ORPHA:847)
- Anemia (HP:0001903): A reduction in erythrocytes volume or hemoglobin concentration. Evidence: TAS. Frequency: Occasional (HP:0040283). (ORPHA:847)
- Nausea and vomiting (HP:0002017): Nausea is a commonly encountered symptom that has been defined as an unpleasant painless subjective feeling that one will imminently vomit. Vomiting has been defined as the forceful expulsion of the contents of the stomach, duodenum, or jejunum through the oral cavity. While nausea and vomiting are often thought to exist on a temporal continuum, this is not always the case. There are situations when severe nausea may be present without emesis and less frequently, when emesis may be present without preceding nausea. Evidence: TAS. Frequency: Occasional (HP:0040283). (ORPHA:847)
- Constipation (HP:0002019): Infrequent or difficult evacuation of feces. Evidence: TAS. Frequency: Occasional (HP:0040283). (ORPHA:847)
- Cerebral cortical atrophy (HP:0002120): Atrophy of the cortex of the cerebrum. Evidence: TAS. Frequency: Occasional (HP:0040283). (ORPHA:847)
- Aganglionic megacolon (HP:0002251): An abnormality resulting from a lack of intestinal ganglion cells (i.e., an aganglionic section of bowel) that results in bowel obstruction with enlargement of the colon. Evidence: TAS. Frequency: Occasional (HP:0040283). (ORPHA:847)
- Infectious encephalitis (HP:0002383): A disorder of the brain caused by an infectious agent that presents with fever, headache, and an altered level of consciousness. There may also be focal or multifocal neurologic deficits, and focal or generalized seizure activity. Evidence: TAS. Frequency: Occasional (HP:0040283). (ORPHA:847)
- Volvulus (HP:0002580): Abnormal twisting of a portion of intestine around itself or around a stalk of mesentery tissue. Evidence: TAS. Frequency: Occasional (HP:0040283). (ORPHA:847)
- Scoliosis (HP:0002650): The presence of an abnormal lateral curvature of the spine. Evidence: TAS. Frequency: Occasional (HP:0040283). (ORPHA:847)
- Clinodactyly of the 5th finger (HP:0004209): Clinodactyly refers to a bending or curvature of the fifth finger in the radial direction (i.e., towards the 4th finger). Evidence: TAS. Frequency: Occasional (HP:0040283). (ORPHA:847)
- Feeding difficulties in infancy (HP:0008872): Impaired feeding performance of an infant as manifested by difficulties such as weak and ineffective sucking, brief bursts of sucking, and falling asleep during sucking. There may be difficulties with chewing or maintaining attention. Evidence: TAS. Frequency: Occasional (HP:0040283). (ORPHA:847)
- Abnormality of movement (HP:0100022): An abnormality of movement with a neurological basis characterized by changes in coordination and speed of voluntary movements. Evidence: TAS. Frequency: Occasional (HP:0040283). (ORPHA:847)
- Self-injurious behavior (HP:0100716): Self-aggression. Evidence: TAS. Frequency: Occasional (HP:0040283). (ORPHA:847)
- Cryptorchidism (HP:0000028): Testis in inguinal canal. That is, absence of one or both testes from the scrotum owing to failure of the testis or testes to descend through the inguinal canal to the scrotum. Evidence: TAS. Frequency: Very frequent (HP:0040281). (ORPHA:847)
- Male pseudohermaphroditism (HP:0000037): Hermaphroditism refers to a discrepancy between the morphology of the gonads and that of the external genitalia. In male pseudohermaphroditism, the genotype is male (XY) and the external genitalia are imcompletely virilized, ambiguous, or complete female. If gonads are present, they are testes. Evidence: TAS. Frequency: Very frequent (HP:0040281). (ORPHA:847)
- Ambiguous genitalia (HP:0000062): A genital phenotype that is not clearly assignable to a single gender. Ambiguous genitalia can be evaluated using the Prader scale: Prader 0: Normal female external genitalia. Prader 1: Female external genitalia with clitoromegaly. Prader 2: Clitoromegaly with partial labial fusion forming a funnel-shaped urogenital sinus. Prader 3: Increased phallic enlargement. Complete labioscrotal fusion forming a urogenital sinus with a single opening. Prader 4: Complete scrotal fusion with urogenital opening at the base or on the shaft of the phallus. Prader 5: Normal male external genitalia. The diagnosis of ambiguous genitalia is made for Prader 1-4. Evidence: TAS. Frequency: Very frequent (HP:0040281). (ORPHA:847)
- Microcephaly (HP:0000252): Head circumference below 2 standard deviations below the mean for age and gender. Evidence: TAS. Frequency: Very frequent (HP:0040281). (ORPHA:847)
- Abnormality of the face (HP:0000271): An abnormality of the face. Evidence: TAS. Frequency: Very frequent (HP:0040281). (ORPHA:847)
- Hypertelorism (HP:0000316): Interpupillary distance more than 2 SD above the mean (alternatively, the appearance of an increased interpupillary distance or widely spaced eyes). Evidence: TAS. Frequency: Very frequent (HP:0040281). (ORPHA:847)
- Atypical behavior (HP:0000708): Atypical behavior is an abnormality in a person's actions that can be controlled or modulated by the will of the individual. While abnormal behaviors can be difficult to control, they are distinct from other abnormal actions that cannot be affected by the individual's will. Evidence: TAS. Frequency: Very frequent (HP:0040281). (ORPHA:847)
- Intellectual disability (HP:0001249): The term intellectual disability or intellectual developmental disorder is used to describe significantly sub-average intellectual and adaptive functioning based on clinical assessment and as measured by individually administered, appropriately normed, standardized and validated tests of intellectual functioning and adaptive behavior, with onset during the developmental period from infancy through adolescence. Evidence: TAS. Frequency: Very frequent (HP:0040281). (ORPHA:847)
- Gastroesophageal reflux (HP:0002020): A condition in which the stomach contents leak backwards from the stomach into the esophagus through the lower esophageal sphincter. Evidence: TAS. Frequency: Very frequent (HP:0040281). (ORPHA:847)
- Aphasia (HP:0002381): An acquired language impairment of some or all of the abilities to produce or comprehend speech and to read or write. Evidence: TAS. Frequency: Very frequent (HP:0040281). (ORPHA:847)
- Abnormality of the male genitalia (HP:0010461): Abnormality of the male genital system. Evidence: TAS. Frequency: Very frequent (HP:0040281). (ORPHA:847)
- Abnormal fontanelle morphology (HP:0011328): An abnormality of the fontanelle. Evidence: TAS. Frequency: Very frequent (HP:0040281). (ORPHA:847)
- Flat face (HP:0012368): Absence of concavity or convexity of the face when viewed in profile. Evidence: TAS. Frequency: Very frequent (HP:0040281). (ORPHA:847)
- Profound global developmental delay (HP:0012736): A profound delay in the achievement of motor or mental milestones in the domains of development of a child. Evidence: TAS. Frequency: Very frequent (HP:0040281). (ORPHA:847)
- Macroglossia (HP:0000158): Increased length and width of the tongue. Evidence: TAS. Frequency: Frequent (HP:0040282). (ORPHA:847)
- Thick lower lip vermilion (HP:0000179): Increased thickness of the lower lip, leading to a prominent appearance of the lower lip. The height of the vermilion of the lower lip in the midline is more than 2 SD above the mean. Alternatively, an apparently increased height of the vermilion of the lower lip in the frontal view (subjective). Evidence: TAS. Frequency: Frequent (HP:0040282). (ORPHA:847)
- Everted lower lip vermilion (HP:0000232): An abnormal configuration of the lower lip such that it is turned outward i.e., everted, with the Inner aspect of the lower lip vermilion (normally opposing the teeth) being visible in a frontal view. Evidence: TAS. Frequency: Frequent (HP:0040282). (ORPHA:847)
- Epicanthus (HP:0000286): A fold of skin starting above the medial aspect of the upper eyelid and arching downward to cover, pass in front of and lateral to the medial canthus. Evidence: TAS. Frequency: Frequent (HP:0040282). (ORPHA:847)
- Depressed nasal ridge (HP:0000457): Lack of prominence of the nose resulting from a posteriorly-placed nasal ridge. Evidence: TAS. Frequency: Frequent (HP:0040282). (ORPHA:847)
- Anteverted nares (HP:0000463): Anteriorly-facing nostrils viewed with the head in the Frankfurt horizontal and the eyes of the observer level with the eyes of the subject. This gives the appearance of an upturned nose (upturned nasal tip). Evidence: TAS. Frequency: Frequent (HP:0040282). (ORPHA:847)
- Visual impairment (HP:0000505): Visual impairment (or vision impairment) is vision loss (of a person) to such a degree as to qualify as an additional support need through a significant limitation of visual capability resulting from either disease, trauma, or congenital or degenerative conditions that cannot be corrected by conventional means, such as refractive correction, medication, or surgery. Evidence: TAS. Frequency: Frequent (HP:0040282). (ORPHA:847)
- Telecanthus (HP:0000506): Distance between the inner canthi more than two standard deviations above the mean (objective); or, apparently increased distance between the inner canthi. Evidence: TAS. Frequency: Frequent (HP:0040282). (ORPHA:847)
- Autism (HP:0000717): Autism is a neurodevelopmental disorder characterized by impaired social interaction and communication, and by restricted and repetitive behavior. Autism begins in childhood. It is marked by the presence of markedly abnormal or impaired development in social interaction and communication and a markedly restricted repertoire of activity and interest. Manifestations of the disorder vary greatly depending on the developmental level and chronological age of the individual (DSM-IV). Evidence: TAS. Frequency: Frequent (HP:0040282). (ORPHA:847)
- Seizure (HP:0001250): A seizure is an intermittent abnormality of nervous system physiology characterized by a transient occurrence of signs and/or symptoms due to abnormal excessive or synchronous neuronal activity in the brain. Evidence: TAS. Frequency: Frequent (HP:0040282). (ORPHA:847)
- Motor delay (HP:0001270): A type of Developmental delay characterized by a delay in acquiring motor skills. Evidence: TAS. Frequency: Frequent (HP:0040282). (ORPHA:847)
- Talipes equinovarus (HP:0001762): Talipes equinovarus (also called clubfoot) typically has four main components: inversion and adduction of the forefoot; inversion of the heel and hindfoot; equinus (limitation of extension) of the ankle and subtalar joint; and internal rotation of the leg. Evidence: TAS. Frequency: Frequent (HP:0040282). (ORPHA:847)
- Drooling (HP:0002307): Habitual flow of saliva out of the mouth. Evidence: TAS. Frequency: Frequent (HP:0040282). (ORPHA:847)
- Sleep disturbance (HP:0002360): An abnormal pattern in the quality, quantity, or characteristics of sleep. Evidence: TAS. Frequency: Frequent (HP:0040282). (ORPHA:847)
- Kyphosis (HP:0002808): Exaggerated anterior convexity of the thoracic vertebral column. Evidence: TAS. Frequency: Frequent (HP:0040282). (ORPHA:847)
- Short stature (HP:0004322): A height below that which is expected according to age and gender norms. Although there is no universally accepted definition of short stature, many refer to "short stature" as height more than 2 standard deviations below the mean for age and gender (or below the 3rd percentile for age and gender dependent norms). Evidence: TAS. Frequency: Frequent (HP:0040282). (ORPHA:847)
- Hypoplasia of penis (HP:0008736). Evidence: TAS. Frequency: Frequent (HP:0040282). (ORPHA:847)
- Tented upper lip vermilion (HP:0010804): Triangular appearance of the oral aperture with the apex in the midpoint of the upper vermilion and the lower vermilion forming the base. Evidence: TAS. Frequency: Frequent (HP:0040282). (ORPHA:847)
- U-Shaped upper lip vermilion (HP:0010806): Gentle upward curve of the upper lip vermilion such that the center is placed well superior to the commissures. Evidence: TAS. Frequency: Frequent (HP:0040282). (ORPHA:847)
- Midface retrusion (HP:0011800): Posterior positions and/or vertical shortening of the infraorbital and perialar regions, or increased concavity of the face and/or reduced nasolabial angle. Evidence: TAS. Frequency: Frequent (HP:0040282). (ORPHA:847)
- Abnormal hemoglobin (HP:0011902): Anomaly in the level or the function of hemoglobin, the oxygen-carrying protein of erythrocytes. Evidence: TAS. Frequency: Frequent (HP:0040282). (ORPHA:847)
- Recurrent urinary tract infections (HP:0000010): Repeated infections of the urinary tract. Evidence: TAS. Frequency: Occasional (HP:0040283). (ORPHA:847)
- Abnormality of the kidney (HP:0000077): An abnormality of the kidney. Evidence: TAS. Frequency: Occasional (HP:0040283). (ORPHA:847)
- Hydronephrosis (HP:0000126): Severe distention of the kidney with dilation of the renal pelvis and calices. Evidence: TAS. Frequency: Occasional (HP:0040283). (ORPHA:847)
- Abnormality of the dentition (HP:0000164): Any abnormality of the teeth. Evidence: TAS. Frequency: Occasional (HP:0040283). (ORPHA:847)
- Sensorineural hearing impairment (HP:0000407): A type of hearing impairment in one or both ears related to an abnormal functionality of the cochlear nerve. Evidence: TAS. Frequency: Occasional (HP:0040283). (ORPHA:847)
- Myopia (HP:0000545): An abnormality of refraction characterized by the ability to see objects nearby clearly, while objects in the distance appear blurry. Evidence: TAS. Frequency: Occasional (HP:0040283). (ORPHA:847)
- Blindness (HP:0000618): Blindness is the condition of lacking visual perception defined as a profound reduction in visual perception. On the 6m visual acuity scale, blindness is defined as less than 3/60. On the 20ft visual acuity scale, blindness is defined as less than 20/400. On the decimal visual acuity scale, blindness is defined as less than 0.05. Blindness is typically characterized by a visual field of no greater than 10 degrees in radius around central fixation. Evidence: TAS. Frequency: Occasional (HP:0040283). (ORPHA:847)